- Autosomal dominant inheritance (HP:0000006): A mode of inheritance that is observed for traits related to a gene encoded on one of the autosomes (i.e., the human chromosomes 1-22) in which a trait manifests in heterozygotes. In the context of medical genetics, an autosomal dominant disorder is caused when a single copy of the mutant allele is present. Males and females are affected equally, and can both transmit the disorder with a risk of 50% for each child of inheriting the mutant allele. Evidence: IEA. (OMIM:151000)
- Intellectual disability (HP:0001249): The term intellectual disability or intellectual developmental disorder is used to describe significantly sub-average intellectual and adaptive functioning based on clinical assessment and as measured by individually administered, appropriately normed, standardized and validated tests of intellectual functioning and adaptive behavior, with onset during the developmental period from infancy through adolescence. Evidence: IEA. (OMIM:151000)
- Abnormality of the skin (HP:0000951): An abnormality of the skin. Evidence: IEA. (OMIM:151000)
These phenotypes are associated with the disease lentiginosis, centrofacial neurodysraphic (OMIM:151000).